Phenotypes associated with the disease Wildervanck syndrome (OMIM:314600):
- Preauricular skin tag (HP:0000384): A rudimentary tag of skin often containing ear tissue including a core of cartilage and located just anterior to the auricle (outer part of the ear). Evidence: IEA. (OMIM:314600)
- Hearing impairment (HP:0000365): A decreased magnitude of the sensory perception of sound. Evidence: IEA. (OMIM:314600)
- Fused cervical vertebrae (HP:0002949): A congenital anomaly characterized by a joining (fusion) of two or more cervical vertebral bodies with one another. Evidence: IEA. (OMIM:314600)
- Pseudopapilledema (HP:0000538): Apparent optic disc swelling in the absence of increased intracranial pressure. Evidence: IEA. (OMIM:314600)
- Abnormality of the outer ear (HP:0000356): An abnormality of the external ear. Evidence: TAS. (OMIM:314600)
- Sporadic (HP:0003745): Cases of the disease in question occur without a previous family history, i.e., as isolated cases without being transmitted from a parent and without other siblings being affected. Evidence: TAS. (OMIM:314600)
- Webbed neck (HP:0000465): Pterygium colli is a congenital skin fold that runs along the sides of the neck down to the shoulders. It involves an ectopic fibrotic facial band superficial to the trapezius muscle. Excess hair-bearing skin is also present and extends down the cervical region well beyond the normal hairline. Evidence: IEA. (OMIM:314600)
- Abducens palsy (HP:0006897): Malfunction of the abducens nerve as manifested by impairment of the ability of the affected eye to be moved outward. Patients who develop abducens nerve palsy often present with binocular horizontal diplopia, which is a double vision when looking at objects side by side. There will be a notable weakness of the ipsilateral lateral rectus muscle leading to a deficit in of eye abduction on the affected side. Some patients may present with a constant head turning movement to maintain binocular fusion and to lessen the degree of diplopia. Evidence: IEA. (OMIM:314600)
- Facial asymmetry (HP:0000324): An abnormal difference between the left and right sides of the face. Evidence: IEA. (OMIM:314600)